- Keloids (HP:0010562). Evidence: IEA. (OMIM:148100)
- Autosomal dominant inheritance (HP:0000006): A mode of inheritance that is observed for traits related to a gene encoded on one of the autosomes (i.e., the human chromosomes 1-22) in which a trait manifests in heterozygotes. In the context of medical genetics, an autosomal dominant disorder is caused when a single copy of the mutant allele is present. Males and females are affected equally, and can both transmit the disorder with a risk of 50% for each child of inheriting the mutant allele. Evidence: IEA. (OMIM:148100)
These phenotypes are associated with the disease keloid formation (OMIM:148100).